Phenotypes associated with the disease Thymoma (ORPHA:99867):
- Weight loss (HP:0001824): Reduction of total body weight. Evidence: TAS. Frequency: Frequent (HP:0040282). (ORPHA:99867)
- Abnormal lymphocyte proliferation (HP:0031378): Any abnormality in the multiplication or reproduction of lymphocytes, which results in the expansion of a cell population. Evidence: TAS. Frequency: Frequent (HP:0040282). (ORPHA:99867)
- Abnormal lymphocyte physiology (HP:0031409): Any anomaly of lymphocyte function. Evidence: TAS. Frequency: Frequent (HP:0040282). (ORPHA:99867)
- Chest pain (HP:0100749): An unpleasant sensation characterized by physical discomfort (such as pricking, throbbing, or aching) localized to the chest. Evidence: TAS. Frequency: Frequent (HP:0040282). (ORPHA:99867)
- Muscle weakness (HP:0001324): Reduced strength of muscles. Evidence: TAS. Frequency: Occasional (HP:0040283). (ORPHA:99867)
- Hoarse voice (HP:0001609): Hoarseness refers to a change in the pitch or quality of the voice, with the voice sounding weak, very breathy, scratchy, or husky. Evidence: TAS. Frequency: Occasional (HP:0040283). (ORPHA:99867)
- Fever (HP:0001945): Body temperature elevated above the normal range. Evidence: TAS. Frequency: Occasional (HP:0040283). (ORPHA:99867)
- Dyspnea (HP:0002094): Difficult or labored breathing. Dyspnea is a subjective feeling only the patient can rate, e.g., on a Borg scale. Evidence: TAS. Frequency: Occasional (HP:0040283). (ORPHA:99867)
- Neoplasm (HP:0002664): An organ or organ-system abnormality that consists of uncontrolled autonomous cell-proliferation which can occur in any part of the body as a benign or malignant neoplasm (tumor). Evidence: TAS. Frequency: Occasional (HP:0040283). (ORPHA:99867)
- Immunodeficiency (HP:0002721): Failure of the immune system to protect the body adequately from infection, due to the absence or insufficiency of some component process or substance. Evidence: TAS. Frequency: Occasional (HP:0040283). (ORPHA:99867)
- Autoimmunity (HP:0002960): The occurrence of an immune reaction against the organism's own cells or tissues. Evidence: TAS. Frequency: Occasional (HP:0040283). (ORPHA:99867)
- Decreased circulating immunoglobulin concentration (HP:0004313): An abnormally decreased level of immunoglobulin in blood. Evidence: TAS. Frequency: Occasional (HP:0040283). (ORPHA:99867)
- Cough (HP:0012735): A sudden, audible expulsion of air from the lungs through a partially closed glottis, preceded by inhalation. Evidence: TAS. Frequency: Occasional (HP:0040283). (ORPHA:99867)
- Night sweats (HP:0030166): Occurrence of excessive sweating during sleep. Evidence: TAS. Frequency: Occasional (HP:0040283). (ORPHA:99867)
- Anti-neuromuscular Junction acetylcholine receptor antibody positivity (HP:0030208): The presence of autoantibodies (immunoglobulins) in the blood circulation that react against neuromuscular junction acetylcholine receptors. Evidence: TAS. Frequency: Occasional (HP:0040283). (ORPHA:99867)
- Abnormal mediastinum morphology (HP:0045026): Any structural anomaly of the central compartment of the thoracic cavity. Evidence: TAS. Frequency: Occasional (HP:0040283). (ORPHA:99867)
- Glomerulonephritis (HP:0000099): Inflammation of the renal glomeruli. Evidence: TAS. Frequency: Very rare (HP:0040284). (ORPHA:99867)
- Abnormality of the nervous system (HP:0000707): An abnormality of the nervous system. Evidence: TAS. Frequency: Very rare (HP:0040284). (ORPHA:99867)
- Rheumatoid arthritis (HP:0001370): Inflammatory changes in the synovial membranes and articular structures with widespread fibrinoid degeneration of the collagen fibers in mesenchymal tissues, as well as atrophy and rarefaction of bony structures. Evidence: TAS. Frequency: Very rare (HP:0040284). (ORPHA:99867)
- Leukemia (HP:0001909): A cancer of the blood and bone marrow characterized by an abnormal proliferation of leukocytes. Evidence: TAS. Frequency: Very rare (HP:0040284). (ORPHA:99867)
- Aplastic anemia (HP:0001915): Aplastic anemia is defined as pancytopenia with a hypocellular marrow. Evidence: TAS. Frequency: Very rare (HP:0040284). (ORPHA:99867)
- Systemic lupus erythematosus (HP:0002725): A chronic, relapsing, inflammatory, and often febrile multisystemic disorder of connective tissue, characterized principally by involvement of the skin, joints, kidneys, and serosal membranes. Evidence: TAS. Frequency: Very rare (HP:0040284). (ORPHA:99867)
- Myalgia (HP:0003326): Pain in muscle. Evidence: TAS. Frequency: Very rare (HP:0040284). (ORPHA:99867)
- Imbalanced hemoglobin synthesis (HP:0005560): Normal hemoglobin synthesis is characterized by production of equal amounts of alpha and beta globins. This term refers to a deviation from this pattern and is the main characteristic of the various forms of thalassemia. Evidence: TAS. Frequency: Very rare (HP:0040284). (ORPHA:99867)
- Demyelinating peripheral neuropathy (HP:0007108): Demyelinating neuropathy is characterized by slow nerve conduction velocities with reduced amplitudes of sensory/motor nerve conduction and prolonged distal latencies. Evidence: TAS. Frequency: Very rare (HP:0040284). (ORPHA:99867)
- Neoplasm of the gastrointestinal tract (HP:0007378): A tumor (abnormal growth of tissue) of the gastrointestinal tract. Evidence: TAS. Frequency: Very rare (HP:0040284). (ORPHA:99867)
- Neoplasm of head and neck (HP:0012288): A tumor (abnormal growth of tissue) of the head and neck region with origin in the lip, oral cavity, nasal cavity, paranasal sinuses, pharynx, or larynx. Evidence: TAS. Frequency: Very rare (HP:0040284). (ORPHA:99867)
- Pure red cell aplasia (HP:0012410): A type of anemia resulting from suppression of erythropoiesis with little or no abnormality of leukocyte or platelet production. Erythroblasts are virtually absent in bone marrow; however, leukocyte and platelet production show little or no reduction. Evidence: TAS. Frequency: Very rare (HP:0040284). (ORPHA:99867)
- Non-Hodgkin lymphoma (HP:0012539): A type of lymphoma characterized microscopically by the absence of multinucleated Reed-Sternberg cells. Evidence: TAS. Frequency: Very rare (HP:0040284). (ORPHA:99867)
- Obstruction of the superior vena cava (HP:0031041): Blockage of blood flow through the superior vena cava (SVC). Because the venous drainage from the upper extremities, upper thorax and head is obstructed, SVC obstruction presents with symptoms related to engorgement of these areas. Both the degree of SVC compromise and the extent of collateral veins determine the varied clinical presentation, which can be as mild as slight facial and upper extremity edema or as dire as intracranial swelling, seizures, hemodynamic instability and tracheal obstruction. Evidence: TAS. Frequency: Very rare (HP:0040284). (ORPHA:99867)
- Neoplasm of the thyroid gland (HP:0100031): A tumor (abnormal growth of tissue) of the thyroid gland. Evidence: TAS. Frequency: Very rare (HP:0040284). (ORPHA:99867)
- Ulcerative colitis (HP:0100279): A chronic inflammatory bowel disease that includes characteristic ulcers, or open sores, in the colon. The main symptom of active disease is usually constant diarrhea mixed with blood, of gradual onset and intermittent periods of exacerbated symptoms contrasting with periods that are relatively symptom-free. In contrast to Crohn's disease this special form of colitis begins in the distal parts of the rectum, spreads continually upwards and affects only mucose and submucose tissue of the colon. Evidence: TAS. Frequency: Very rare (HP:0040284). (ORPHA:99867)
- Scleroderma (HP:0100324): A chronic autoimmune phenomenon characterized by fibrosis (or hardening) and vascular alterations of the skin. Evidence: TAS. Frequency: Very rare (HP:0040284). (ORPHA:99867)
- Neoplasm of the lung (HP:0100526): Tumor of the lung. Evidence: TAS. Frequency: Very rare (HP:0040284). (ORPHA:99867)
- Neoplasia of the pleura (HP:0100527). Evidence: TAS. Frequency: Very rare (HP:0040284). (ORPHA:99867)
- Myositis (HP:0100614): A general term for inflammation of the muscles without respect to the underlying cause. Evidence: TAS. Frequency: Very rare (HP:0040284). (ORPHA:99867)
- Prostate neoplasm (HP:0100787). Evidence: TAS. Frequency: Very rare (HP:0040284). (ORPHA:99867)